Phenotypes associated with the disease hearing loss, autosomal recessive 122 (OMIM:620714):
- Sensorineural hearing impairment (HP:0000407): A type of hearing impairment in one or both ears related to an abnormal functionality of the cochlear nerve. Evidence: PCS. Frequency: 2/2. (PMID:37943620)
- Adult onset (HP:0003581): Onset of disease manifestations in adulthood, defined here as at the age of 16 years or later. Evidence: PCS. Frequency: 2/2. (PMID:37943620)
- Autosomal recessive inheritance (HP:0000007): A mode of inheritance that is observed for traits related to a gene encoded on one of the autosomes (i.e., the human chromosomes 1-22) in which a trait manifests in individuals with two pathogenic alleles, either homozygotes (two copies of the same mutant allele) or compound heterozygotes (whereby each copy of a gene has a distinct mutant allele). Evidence: PCS. (PMID:37943620)